- Diabetes insipidus (HP:0000873): A state of excessive water intake and hypotonic (dilute) polyuria. Diabetes insipidus may be due to failure of vasopressin (AVP) release (central or neurogenic diabetes insipidus) or to a failure of the kidney to respond to AVP (nephrogenic diabetes insipidus). Evidence: TAS. Frequency: Very frequent (HP:0040281). (ORPHA:95626)
- Weight loss (HP:0001824): Reduction of total body weight. Evidence: TAS. Frequency: Frequent (HP:0040282). (ORPHA:95626)
- Polydipsia (HP:0001959): Excessive thirst manifested by excessive fluid intake. Evidence: TAS. Frequency: Very frequent (HP:0040281). (ORPHA:95626)
- Pollakisuria (HP:0100515): Increased frequency of urination. Evidence: TAS. Frequency: Very frequent (HP:0040281). (ORPHA:95626)
These phenotypes are associated with the disease Acquired arginine vasopressin deficiency (ORPHA:95626).